- Abnormality of the skeletal system (HP:0000924): An abnormality of the skeletal system. Evidence: IEA. (OMIM:314100)
- X-linked recessive inheritance (HP:0001419): A mode of inheritance that is observed for recessive traits related to a gene encoded on the X chromosome. In the context of medical genetics, X-linked recessive disorders manifest in males (who have one copy of the X chromosome and are thus hemizygotes), but generally not in female heterozygotes who have one mutant and one normal allele. Evidence: IEA. (OMIM:314100)
- Abnormality of the nervous system (HP:0000707): An abnormality of the nervous system. Evidence: IEA. (OMIM:314100)
These phenotypes are associated with the disease thumbs, congenital Clasped (OMIM:314100).